- Abnormality of the endocrine system (HP:0000818): An abnormality of the endocrine system. Evidence: IEA. (OMIM:300488)
- X-linked dominant inheritance (HP:0001423): A mode of inheritance that is observed for dominant traits related to a gene encoded on the X chromosome. In the context of medical genetics, X-linked dominant disorders tend to manifest very severely in affected males. The severity of manifestation in females may depend on the degree of skewed X inactivation. Evidence: IEA. (OMIM:300488)
These phenotypes are associated with the disease MENOPAUSE, NATURAL, AGE AT, QUANTITATIVE TRAIT LOCUS 1 (OMIM:300488).